Phenotypes associated with the disease POEMS syndrome (ORPHA:2905):
- Polyneuropathy (HP:0001271): A generalized disorder of peripheral nerves. Evidence: TAS. Frequency: Obligate (HP:0040280). (ORPHA:2905)
- Hypogonadism (HP:0000135): A decreased functionality of the gonad. Evidence: TAS. Frequency: Very frequent (HP:0040281). (ORPHA:2905)
- Abnormality of the endocrine system (HP:0000818): An abnormality of the endocrine system. Evidence: TAS. Frequency: Very frequent (HP:0040281). (ORPHA:2905)
- Visceromegaly (HP:0003271): Abnormal increased size of the viscera of the abdomen. Evidence: TAS. Frequency: Very frequent (HP:0040281). (ORPHA:2905)
- Lymphoproliferative disorder (HP:0005523). Evidence: TAS. Frequency: Very frequent (HP:0040281). (ORPHA:2905)
- Increased circulating immunoglobulin concentration (HP:0010702): An increased level of gamma globulin (immunoglobulin) in the blood. Evidence: TAS. Frequency: Very frequent (HP:0040281). (ORPHA:2905)
- Abnormal skin physiology (HP:0011122): Any abnormality of the physiological function of the skin. Evidence: TAS. Frequency: Very frequent (HP:0040281). (ORPHA:2905)
- Gynecomastia (HP:0000771): Abnormal development of large mammary glands in males resulting in breast enlargement. Evidence: TAS. Frequency: Frequent (HP:0040282). (ORPHA:2905)
- Diabetes mellitus (HP:0000819): A group of abnormalities characterized by hyperglycemia and glucose intolerance. Evidence: TAS. Frequency: Frequent (HP:0040282). (ORPHA:2905)
- Hypothyroidism (HP:0000821): Deficiency of thyroid hormone. Evidence: TAS. Frequency: Frequent (HP:0040282). (ORPHA:2905)
- Hyperpigmentation of the skin (HP:0000953): A darkening of the skin related to an increase in melanin production and deposition. Evidence: TAS. Frequency: Frequent (HP:0040282). (ORPHA:2905)
- Edema (HP:0000969): An abnormal accumulation of fluid beneath the skin, or in one or more cavities of the body. Evidence: TAS. Frequency: Frequent (HP:0040282). (ORPHA:2905)
- Hypertrichosis (HP:0000998): Hypertrichosis is increased hair growth that is abnormal in quantity or location. Evidence: TAS. Frequency: Frequent (HP:0040282). (ORPHA:2905)
- Hemangioma (HP:0001028): A hemangioma is a benign tumor characterized by blood-filled spaces lined by benign endothelial cells. A hemangioma characterized by large endothelial spaces (caverns) is called a cavernous hemangioma (in contrast to a hemangioma with small endothelial spaces, which is called capillary hemangioma). Evidence: TAS. Frequency: Frequent (HP:0040282). (ORPHA:2905)
- Thickened skin (HP:0001072): Laminar thickening of skin. Evidence: TAS. Frequency: Frequent (HP:0040282). (ORPHA:2905)
- Papilledema (HP:0001085): Papilledema refers to edema (swelling) of the optic disc secondary to any factor which increases cerebral spinal fluid pressure. Evidence: TAS. Frequency: Frequent (HP:0040282). (ORPHA:2905)
- Areflexia (HP:0001284): Absence of neurologic reflexes such as the knee-jerk reaction. Evidence: TAS. Frequency: Frequent (HP:0040282). (ORPHA:2905)
- Muscle weakness (HP:0001324): Reduced strength of muscles. Evidence: TAS. Frequency: Frequent (HP:0040282). (ORPHA:2905)
- Ascites (HP:0001541): Accumulation of fluid in the peritoneal cavity (between the layers of the peritoneum that lines the abdomen). Evidence: TAS. Frequency: Frequent (HP:0040282). (ORPHA:2905)
- Pericardial effusion (HP:0001698): Accumulation of fluid within the pericardium. Evidence: TAS. Frequency: Frequent (HP:0040282). (ORPHA:2905)
- Splenomegaly (HP:0001744): Abnormal increased size of the spleen. Evidence: TAS. Frequency: Frequent (HP:0040282). (ORPHA:2905)
- Leukonychia (HP:0001820): White discoloration of the nails. Evidence: TAS. Frequency: Frequent (HP:0040282). (ORPHA:2905)
- Weight loss (HP:0001824): Reduction of total body weight. Evidence: TAS. Frequency: Frequent (HP:0040282). (ORPHA:2905)
- Thrombocytosis (HP:0001894): Increased numbers of platelets in the peripheral blood. Evidence: TAS. Frequency: Frequent (HP:0040282). (ORPHA:2905)
- Pulmonary arterial hypertension (HP:0002092): Pulmonary hypertension is defined mean pulmonary artery pressure of 25mmHg or more and pulmonary capillary wedge pressure of 15mmHg or less when measured by right heart catheterisation at rest and in a supine position. Evidence: TAS. Frequency: Frequent (HP:0040282). (ORPHA:2905)
- Pleural effusion (HP:0002202): The presence of an excessive amount of fluid in the pleural cavity. Evidence: TAS. Frequency: Frequent (HP:0040282). (ORPHA:2905)
- Hepatomegaly (HP:0002240): Abnormally increased size of the liver. Evidence: TAS. Frequency: Frequent (HP:0040282). (ORPHA:2905)
- Sclerosis of skull base (HP:0002694): Increased bone density of the skull base without significant changes in bony contour. Evidence: TAS. Frequency: Frequent (HP:0040282). (ORPHA:2905)
- Lymphadenopathy (HP:0002716): Enlargement (swelling) of a lymph node. Evidence: TAS. Frequency: Frequent (HP:0040282). (ORPHA:2905)
- Paresthesia (HP:0003401): Abnormal sensations such as tingling, pricking, or numbness of the skin with no apparent physical cause. Evidence: TAS. Frequency: Frequent (HP:0040282). (ORPHA:2905)
- Sclerosis of hand bone (HP:0004054): Osteosclerosis affecting one or more bones of the hand. Evidence: TAS. Frequency: Frequent (HP:0040282). (ORPHA:2905)
- Sclerotic vertebral endplates (HP:0004576): Sclerosis (increased density) affecting vertebral end plates. Evidence: TAS. Frequency: Frequent (HP:0040282). (ORPHA:2905)
- Metaphyseal sclerosis (HP:0004979): Abnormally increased density of metaphyseal bone. Evidence: TAS. Frequency: Frequent (HP:0040282). (ORPHA:2905)
- Primary adrenal insufficiency (HP:0008207): Insufficient production of steroid hormones (primarily cortisol) by the adrenal glands as a result of a primary defect in the glands themselves. Evidence: TAS. Frequency: Frequent (HP:0040282). (ORPHA:2905)
- Fatigue (HP:0012378): A subjective feeling of tiredness characterized by a lack of energy and motivation. Evidence: TAS. Frequency: Frequent (HP:0040282). (ORPHA:2905)
- Pain (HP:0012531): An unpleasant sensory and emotional experience associated with actual or potential tissue damage, or described in terms of such damage. Evidence: TAS. Frequency: Frequent (HP:0040282). (ORPHA:2905)
- Elevated vascular endothelial growth factor level (HP:0031052): Increased blood concentration of vascular endothelial growth factor (VEGF). Evidence: TAS. Frequency: Frequent (HP:0040282). (ORPHA:2905)
- Erectile dysfunction (HP:0100639): A multidimensional but common male sexual dysfunction that involves an alteration in any of the components of the erectile response, including organic, relational and psychological. Evidence: TAS. Frequency: Frequent (HP:0040282). (ORPHA:2905)
- Clubbing of fingers (HP:0100759): Terminal broadening of the fingers (distal phalanges of the fingers). Evidence: TAS. Frequency: Frequent (HP:0040282). (ORPHA:2905)
- Sclerosis of foot bone (HP:0100925): An elevation in bone density in one or more foot bones. Sclerosis is normally detected on a radiograph as an area of increased opacity. Evidence: TAS. Frequency: Frequent (HP:0040282). (ORPHA:2905)
- Increased circulating prolactin concentration (HP:0000870): The presence of abnormally increased levels of prolactin in the blood. Prolactin is a peptide hormone produced by the anterior pituitary gland that plays a role in breast development and lactation during pregnancy. Evidence: TAS. Frequency: Occasional (HP:0040283). (ORPHA:2905)
- Plethora (HP:0001050). Evidence: TAS. Frequency: Occasional (HP:0040283). (ORPHA:2905)
- Acrocyanosis (HP:0001063): Bluish discoloration of the skin of the hands or feet. Evidence: TAS. Frequency: Occasional (HP:0040283). (ORPHA:2905)
- Polycythemia (HP:0001901): Polycythemia is diagnosed if the red blood cell count, the hemoglobin level, and the red blood cell volume all exceed the upper limits of normal. Evidence: TAS. Frequency: Occasional (HP:0040283). (ORPHA:2905)
- Restrictive ventilatory defect (HP:0002091): A functional defect characterized by reduced total lung capacity (TLC) not associated with abnormalities of expiratory airflow or airway resistance. Spirometrically, a restrictive defect is defined as FEV1 (forced expiratory volume in 1 second) and FVC (forced vital capacity) less than 80 per cent. Restrictive lung disease may be caused by alterations in lung parenchyma or because of a disease of the pleura, chest wall, or neuromuscular apparatus. Evidence: TAS. Frequency: Occasional (HP:0040283). (ORPHA:2905)
- Respiratory insufficiency due to muscle weakness (HP:0002747). Evidence: TAS. Frequency: Occasional (HP:0040283). (ORPHA:2905)
- Arterial thrombosis (HP:0004420): The formation of a blood clot inside an artery. Evidence: TAS. Frequency: Occasional (HP:0040283). (ORPHA:2905)
- Venous thrombosis (HP:0004936): Formation of a blood clot (thrombus) inside a vein, causing the obstruction of blood flow. Evidence: TAS. Frequency: Occasional (HP:0040283). (ORPHA:2905)
- Lipodystrophy (HP:0009125): Degenerative changes of the fat tissue. Evidence: TAS. Frequency: Occasional (HP:0040283). (ORPHA:2905)
- Glomeruloid hemangioma (HP:0031357): A histologically distinctive, cutaneous, benign vascular tumor that is characterized by a solitary or multiple blue-red papules and histologically resembles renal glomeruli. Evidence: TAS. Frequency: Occasional (HP:0040283). (ORPHA:2905)
- Hyperesthesia (HP:0100963): Increased sensitivity to stimulation, excluding the special senses, which may refer to various modes of cutaneous sensibility including touch and thermal sensation without pain, as well as to pain. Evidence: TAS. Frequency: Occasional (HP:0040283). (ORPHA:2905)